- Congenital, generalized hypertrichosis (HP:0004540): A confluent, generalized overgrowth of silvery blonde to gray lanugo hair at birth. Evidence: IEA. (OMIM:145700)
- Double eyebrow (HP:0010730): This may present as a partial or complete duplication of the eyebrows. Evidence: IEA. (OMIM:145700)
- Autosomal dominant inheritance (HP:0000006): A mode of inheritance that is observed for traits related to a gene encoded on one of the autosomes (i.e., the human chromosomes 1-22) in which a trait manifests in heterozygotes. In the context of medical genetics, an autosomal dominant disorder is caused when a single copy of the mutant allele is present. Males and females are affected equally, and can both transmit the disorder with a risk of 50% for each child of inheriting the mutant allele. Evidence: IEA. (OMIM:145700)
These phenotypes are associated with the disease hypertrichosis lanuginosa congenita (OMIM:145700).